- Abnormal lower lip morphology (HP:0000178): An abnormality of the lower lip. Evidence: TAS. Frequency: Very frequent (HP:0040281). (ORPHA:1166)
- Asymmetric crying face (HP:0011333): Asymmetry observed in the face of a neonate or infant whose face appears symmetric at rest and asymmetric during crying as the mouth is pulled downward on one side while not moving on the other side. Evidence: TAS. Frequency: Very frequent (HP:0040281). (ORPHA:1166)
- Cryptorchidism (HP:0000028): Testis in inguinal canal. That is, absence of one or both testes from the scrotum owing to failure of the testis or testes to descend through the inguinal canal to the scrotum. Evidence: TAS. Frequency: Frequent (HP:0040282). (ORPHA:1166)
- Vesicoureteral reflux (HP:0000076): Abnormal (retrograde) movement of urine from the bladder into ureters or kidneys related to inadequacy of the valvular mechanism at the ureterovesicular junction or other causes. Evidence: TAS. Frequency: Frequent (HP:0040282). (ORPHA:1166)
- Cleft palate (HP:0000175): Cleft palate is a developmental defect of the palate resulting from a failure of fusion of the palatine processes and manifesting as a separation of the roof of the mouth (soft and hard palate). Evidence: TAS. Frequency: Frequent (HP:0040282). (ORPHA:1166)
- Microcephaly (HP:0000252): Head circumference below 2 standard deviations below the mean for age and gender. Evidence: TAS. Frequency: Frequent (HP:0040282). (ORPHA:1166)
- Micrognathia (HP:0000347): Developmental hypoplasia of the mandible. Evidence: TAS. Frequency: Frequent (HP:0040282). (ORPHA:1166)
- Protruding ear (HP:0000411): Angle formed by the plane of the ear and the mastoid bone greater than the 97th centile for age (objective); or, outer edge of the helix more than 2 cm from the mastoid at the point of maximum distance (objective). Evidence: TAS. Frequency: Frequent (HP:0040282). (ORPHA:1166)
- Congenital diaphragmatic hernia (HP:0000776): The presence of a hernia of the diaphragm present at birth. Evidence: TAS. Frequency: Frequent (HP:0040282). (ORPHA:1166)
- Hypertonia (HP:0001276): A condition in which there is increased muscle tone so that arms or legs, for example, are stiff and difficult to move. Evidence: TAS. Frequency: Frequent (HP:0040282). (ORPHA:1166)
- Joint stiffness (HP:0001387): Joint stiffness is a perceived sensation of tightness in a joint or joints when attempting to move them after a period of inactivity. Joint stiffness typically subsides over time. Evidence: TAS. Frequency: Frequent (HP:0040282). (ORPHA:1166)
- Respiratory insufficiency (HP:0002093). Evidence: TAS. Frequency: Frequent (HP:0040282). (ORPHA:1166)
- Cerebral cortical atrophy (HP:0002120): Atrophy of the cortex of the cerebrum. Evidence: TAS. Frequency: Frequent (HP:0040282). (ORPHA:1166)
- Short stature (HP:0004322): A height below that which is expected according to age and gender norms. Although there is no universally accepted definition of short stature, many refer to "short stature" as height more than 2 standard deviations below the mean for age and gender (or below the 3rd percentile for age and gender dependent norms). Evidence: TAS. Frequency: Frequent (HP:0040282). (ORPHA:1166)
- Multiple renal cysts (HP:0005562): The presence of many cysts in the kidney. Evidence: TAS. Frequency: Frequent (HP:0040282). (ORPHA:1166)
- Renal hypoplasia/aplasia (HP:0008678): Absence or underdevelopment of the kidney. Evidence: TAS. Frequency: Frequent (HP:0040282). (ORPHA:1166)
- Tooth agenesis (HP:0009804): The absence of one or more teeth from the normal series by a failure to develop. Evidence: TAS. Frequency: Frequent (HP:0040282). (ORPHA:1166)
- Global developmental delay (HP:0001263): A delay in the achievement of motor or mental milestones in the domains of development of a child, including motor skills, speech and language, cognitive skills, and social and emotional skills. This term should only be used to describe children younger than five years of age. Evidence: TAS. Frequency: Occasional (HP:0040283). (ORPHA:1166)
- Ventricular septal defect (HP:0001629): A hole between the two bottom chambers (ventricles) of the heart. The defect is centered around the most superior aspect of the ventricular septum. Evidence: TAS. Frequency: Occasional (HP:0040283). (ORPHA:1166)
- Tetralogy of Fallot (HP:0001636): A congenital cardiac malformation comprising pulmonary stenosis, overriding aorta, ventricular septum defect, and right ventricular hypertrophy. The diagnosis of TOF is made if at least three of the four above mentioned features are present. Evidence: TAS. Frequency: Occasional (HP:0040283). (ORPHA:1166)
- Abnormal aortic morphology (HP:0001679): An abnormality of the aorta. Evidence: TAS. Frequency: Occasional (HP:0040283). (ORPHA:1166)
- Abnormality of the respiratory system (HP:0002086): An abnormality of the respiratory system, which include the airways, lungs, and the respiratory muscles. Evidence: TAS. Frequency: Occasional (HP:0040283). (ORPHA:1166)
- Abnormal hip bone morphology (HP:0003272): An abnormality of the hip bone. Evidence: TAS. Frequency: Occasional (HP:0040283). (ORPHA:1166)
- Vertebral segmentation defect (HP:0003422): An abnormality related to a defect of vertebral separation during development. Evidence: TAS. Frequency: Occasional (HP:0040283). (ORPHA:1166)
- Abnormality of the pulmonary artery (HP:0004414): An abnormality of the pulmonary artery. Evidence: TAS. Frequency: Occasional (HP:0040283). (ORPHA:1166)
- Abnormal cardiovascular system morphology (HP:0030680): Any structural anomaly of the heart and blood vessels. Evidence: TAS. Frequency: Occasional (HP:0040283). (ORPHA:1166)
These phenotypes are associated with the disease Congenital unilateral hypoplasia of depressor anguli oris (ORPHA:1166).